Phenotypes associated with the disease isolated anhidrosis with normal sweat glands (OMIM:106190):
- Abnormal hair morphology (HP:0001595): An abnormality of the hair. Evidence: PCS. Frequency: 0/5. (PMID:25329695)
- Heat intolerance (HP:0002046): The inability to maintain a comfortable body temperature in warm or hot weather. Evidence: PCS. Frequency: 5/5. (PMID:25329695)
- Growth abnormality (HP:0001507). Evidence: PCS. Frequency: 0/5. (PMID:25329695)
- Autosomal recessive inheritance (HP:0000007): A mode of inheritance that is observed for traits related to a gene encoded on one of the autosomes (i.e., the human chromosomes 1-22) in which a trait manifests in individuals with two pathogenic alleles, either homozygotes (two copies of the same mutant allele) or compound heterozygotes (whereby each copy of a gene has a distinct mutant allele). Evidence: PCS. (PMID:25329695)
- Generalized anhidrosis (HP:0007459). Evidence: PCS. Frequency: 5/5. (PMID:25329695)